- Microcephaly (HP:0000252): Head circumference below 2 standard deviations below the mean for age and gender. Evidence: PCS. Frequency: 0/7. (PMID:18452889)
- Childhood onset (HP:0011463): Onset of disease at the age of between 1 and 5 years. Evidence: PCS. Frequency: 2/2. (PMID:18455129)
- Global developmental delay (HP:0001263): A delay in the achievement of motor or mental milestones in the domains of development of a child, including motor skills, speech and language, cognitive skills, and social and emotional skills. This term should only be used to describe children younger than five years of age. Evidence: PCS. Frequency: 2/2. (PMID:18455129)
- Autosomal recessive inheritance (HP:0000007): A mode of inheritance that is observed for traits related to a gene encoded on one of the autosomes (i.e., the human chromosomes 1-22) in which a trait manifests in individuals with two pathogenic alleles, either homozygotes (two copies of the same mutant allele) or compound heterozygotes (whereby each copy of a gene has a distinct mutant allele). Evidence: PCS. (PMID:18452889)
- Intellectual disability (HP:0001249): The term intellectual disability or intellectual developmental disorder is used to describe significantly sub-average intellectual and adaptive functioning based on clinical assessment and as measured by individually administered, appropriately normed, standardized and validated tests of intellectual functioning and adaptive behavior, with onset during the developmental period from infancy through adolescence. Evidence: PCS. Frequency: 7/7. (PMID:18452889)
- Severe intellectual disability (HP:0010864): Severe intellectual disability (ID) is defined as a type of ID characterized by severely sub-average adaptive functioning and intellectual functioning, with an intelligence quotient (IQ) the range of 20-34. Evidence: PCS. Frequency: 2/2. (PMID:18455129)
These phenotypes are associated with the disease intellectual disability, autosomal recessive 7 (OMIM:611093).